Phenotypes associated with the disease anal canal carcinoma (OMIM:105580):
- Anal canal squamous carcinoma (HP:0006763). Evidence: IEA. (OMIM:105580)
- Autosomal dominant inheritance (HP:0000006): A mode of inheritance that is observed for traits related to a gene encoded on one of the autosomes (i.e., the human chromosomes 1-22) in which a trait manifests in heterozygotes. In the context of medical genetics, an autosomal dominant disorder is caused when a single copy of the mutant allele is present. Males and females are affected equally, and can both transmit the disorder with a risk of 50% for each child of inheriting the mutant allele. Evidence: IEA. (OMIM:105580)